- Epileptic spasm (HP:0011097): A sudden flexion, extension, or mixed extension-flexion of predominantly proximal and truncal muscles that is usually more sustained than a myoclonic movement but not as sustained as a tonic seizure. Limited forms may occur: Grimacing, head nodding, or subtle eye movements. Epileptic spasms frequently occur in clusters. Infantile spasms are the best known form, but spasms can occur at all ages. Evidence: PCS. Frequency: 1/2. (PMID:31675180)
- Profound intellectual disability (HP:0002187): Profound intellectual disability (ID) is defined as a type of ID characterized by profoundly sub-average adaptive functioning and intellectual functioning, with an intelligence quotient (IQ) below 20. Evidence: PCS. Frequency: 1/1. (PMID:31675180)
- Small for gestational age (HP:0001518): Smaller than normal size according to sex and gestational age related norms, defined as a weight below the 10th percentile for the gestational age. Evidence: PCS. Frequency: 1/2. (PMID:31675180)
- Tonic seizure (HP:0032792): A tonic seizure is a type of motor seizure characterized by unilateral or bilateral limb stiffening or elevation, often with neck stiffening. Evidence: PCS. Frequency: 1/2. (PMID:31675180)
- Primary microcephaly (HP:0011451): Head circumference below 2 standard deviations below the mean for age and gender at birth. Evidence: PCS. Frequency: 1/2. (PMID:31675180)
- EEG with burst suppression (HP:0010851): The burst suppression pattern in electroencephalography refers to a characteristic periodic pattern of low voltage (<10 microvolts) suppressed background and a relatively shorter pattern of higher amplitude slow, sharp, and spiking complexes. Evidence: PCS. Frequency: 2/2. (PMID:31675180)
- Hydrops fetalis (HP:0001789): The abnormal accumulation of fluid in two or more fetal compartments, including ascites, pleural effusion, pericardial effusion, and skin edema. Evidence: PCS. Frequency: 1/2. (PMID:31675180)
- Epileptic encephalopathy (HP:0200134): A condition in which epileptiform abnormalities are believed to contribute to the progressive disturbance in cerebral function. Epileptic encephalaopathy is characterized by (1) electrographic EEG paroxysmal activity that is often aggressive, (2) seizures that are usually multiform and intractable, (3) cognitive, behavioral and neurological deficits that may be relentless, and (4) sometimes early death. Evidence: PCS. Frequency: 2/2. (PMID:31675180)
- Death in infancy (HP:0001522): Death within the first 24 months of life. Evidence: PCS. Frequency: 1/2. (PMID:31675180)
- Autosomal dominant inheritance (HP:0000006): A mode of inheritance that is observed for traits related to a gene encoded on one of the autosomes (i.e., the human chromosomes 1-22) in which a trait manifests in heterozygotes. In the context of medical genetics, an autosomal dominant disorder is caused when a single copy of the mutant allele is present. Males and females are affected equally, and can both transmit the disorder with a risk of 50% for each child of inheriting the mutant allele. Evidence: PCS. (PMID:31675180)
- Neonatal respiratory distress (HP:0002643): Respiratory difficulty as newborn. Evidence: PCS. Frequency: 2/2. (PMID:31675180)
These phenotypes are associated with the disease developmental and epileptic encephalopathy 96 (OMIM:619340).